Phenotypes associated with the disease intellectual disability, autosomal recessive 63 (OMIM:618095, an entry in Online Mendelian Inheritance in Man):
- Inability to walk (HP:0002540, a Human Phenotype Ontology term): Incapability to ambulate. Evidence: PCS. Frequency: 2/2. (PMID:29784083)
- Absent speech (HP:0001344, a Human Phenotype Ontology term): Complete lack of development of speech and language abilities. Evidence: PCS. Frequency: 2/2. (PMID:29784083)
- Interictal epileptiform activity (HP:0011182, a Human Phenotype Ontology term): Epileptiform activity refers to distinctive EEG waves or complexes distinguished from background activity found in in a proportion of human subjects with epilepsy, but which can also be found in subjects without seizures. Interictal epileptiform activity refers to such activity that occurs in the absence of a clinical or subclinical seizure. Evidence: PCS. Frequency: 1/1. (PMID:29784083)
- Global developmental delay (HP:0001263, a Human Phenotype Ontology term): A delay in the achievement of motor or mental milestones in the domains of development of a child, including motor skills, speech and language, cognitive skills, and social and emotional skills. This term should only be used to describe children younger than five years of age. Evidence: PCS. Frequency: 2/2. (PMID:29784083)
- Hypotonia (HP:0001252, a Human Phenotype Ontology term): Hypotonia is an abnormally low muscle tone (the amount of tension or resistance to movement in a muscle). Even when relaxed, muscles have a continuous and passive partial contraction which provides some resistance to passive stretching. Hypotonia thus manifests as diminished resistance to passive stretching. Hypotonia is not the same as muscle weakness, although the two conditions can co-exist. Evidence: PCS. Frequency: 2/2. (PMID:29784083)
- Infantile onset (HP:0003593, a Human Phenotype Ontology term): Onset of signs or symptoms of disease between 28 days to one year of life. Evidence: PCS. Frequency: 2/2. (PMID:29784083)
- Myoclonic seizure (HP:0032794, a Human Phenotype Ontology term): A myoclonic seizure is a type of motor seizure characterized by sudden, brief (<100 ms) involuntary single or multiple contraction of muscles or muscle groups of variable topography (axial, proximal limb, distal). Myoclonus is less regularly repetitive and less sustained than is clonus. Evidence: PCS. Frequency: 2/2. (PMID:29784083)
- Autosomal recessive inheritance (HP:0000007, a Human Phenotype Ontology term): A mode of inheritance that is observed for traits related to a gene encoded on one of the autosomes (i.e., the human chromosomes 1-22) in which a trait manifests in individuals with two pathogenic alleles, either homozygotes (two copies of the same mutant allele) or compound heterozygotes (whereby each copy of a gene has a distinct mutant allele). Evidence: PCS. (PMID:29784083)
- Spasticity (HP:0001257, a Human Phenotype Ontology term): A motor disorder characterized by a velocity-dependent increase in tonic stretch reflexes with increased muscle tone, exaggerated (hyperexcitable) tendon reflexes. Evidence: PCS. Frequency: 2/2. (PMID:29784083)
- Severe intellectual disability (HP:0010864, a Human Phenotype Ontology term): Severe intellectual disability (ID) is defined as a type of ID characterized by severely sub-average adaptive functioning and intellectual functioning, with an intelligence quotient (IQ) the range of 20-34. Evidence: PCS. Frequency: 2/2. (PMID:29784083)